- Hand tremor (HP:0002378): An unintentional, oscillating to-and-fro muscle movement affecting the hand. Evidence: PCS. (PMID:2766660)
- Generalized muscle weakness (HP:0003324): Generalized weakness or decreased strength of the muscles, affecting both distal and proximal musculature. Evidence: PCS. (PMID:2766660)
- Hyperkalemia (HP:0002153): The concentration of potassium(1+) in the blood circulation is above the upper limit of normal. Evidence: TAS. (OMIM:609153)
- Muscle spasm (HP:0003394): Sudden and involuntary contractions of one or more muscles. Evidence: PCS. (PMID:2766660)
- Hemolytic anemia (HP:0001878): A type of anemia caused by premature destruction of red blood cells (hemolysis). Evidence: PCS. Frequency: 0/2. (PMID:24947683)
- Periodic paralysis (HP:0003768): Episodes of muscle weakness. Evidence: PCS. (PMID:2766660)
- Autosomal dominant inheritance (HP:0000006): A mode of inheritance that is observed for traits related to a gene encoded on one of the autosomes (i.e., the human chromosomes 1-22) in which a trait manifests in heterozygotes. In the context of medical genetics, an autosomal dominant disorder is caused when a single copy of the mutant allele is present. Males and females are affected equally, and can both transmit the disorder with a risk of 50% for each child of inheriting the mutant allele. Evidence: PCS. (PMID:24947683)
These phenotypes are associated with the disease familial pseudohyperkalemia (OMIM:609153).